Phenotypes associated with the disease Christianson syndrome (ORPHA:85278):
- Drooling (HP:0002307): Habitual flow of saliva out of the mouth. Evidence: TAS. Frequency: Frequent (HP:0040282). (ORPHA:85278)
- EEG abnormality (HP:0002353): Abnormality observed by electroencephalogram (EEG), which is used to record of the brain's spontaneous electrical activity from multiple electrodes placed on the scalp. Evidence: TAS. Frequency: Frequent (HP:0040282). (ORPHA:85278)
- Hyperkinetic movements (HP:0002487): Motor hyperactivity with excessive movement of muscles of the body as a whole. Evidence: TAS. Frequency: Frequent (HP:0040282). (ORPHA:85278)
- Secondary microcephaly (HP:0005484): Head circumference which falls below 2 standard deviations below the mean for age and gender because of insufficient head growth after birth. Evidence: TAS. Frequency: Frequent (HP:0040282). (ORPHA:85278)
- Aplasia/Hypoplasia of the corpus callosum (HP:0007370): Absence or underdevelopment of the corpus callosum. Evidence: TAS. Frequency: Frequent (HP:0040282). (ORPHA:85278)
- Feeding difficulties in infancy (HP:0008872): Impaired feeding performance of an infant as manifested by difficulties such as weak and ineffective sucking, brief bursts of sucking, and falling asleep during sucking. There may be difficulties with chewing or maintaining attention. Evidence: TAS. Frequency: Frequent (HP:0040282). (ORPHA:85278)
- Feeding difficulties (HP:0011968): Impaired ability to eat related to problems gathering food and getting ready to suck, chew, or swallow it. Evidence: TAS. Frequency: Frequent (HP:0040282). (ORPHA:85278)
- Conspicuously happy disposition (HP:0100024): An unusually happy demeanor over time, which can also be observed during inappropriate situations that should, for example, cause distress, fear, or anger. Evidence: TAS. Frequency: Frequent (HP:0040282). (ORPHA:85278)
- Deeply set eye (HP:0000490): An eye that is more deeply recessed into the plane of the face than is typical. Evidence: TAS. Frequency: Occasional (HP:0040283). (ORPHA:85278)
- Osteoporosis (HP:0000939): Osteoporosis is a systemic skeletal disease characterized by low bone density and microarchitectural deterioration of bone tissue with a consequent increase in bone fragility. According to the WHO criteria, osteoporosis is defined as a BMD that lies 2.5 standard deviations or more below the average value for young healthy adults (a T-score below -2.5 SD). Evidence: TAS. Frequency: Occasional (HP:0040283). (ORPHA:85278)
- Sleep disturbance (HP:0002360): An abnormal pattern in the quality, quantity, or characteristics of sleep. Evidence: TAS. Frequency: Occasional (HP:0040283). (ORPHA:85278)
- Scoliosis (HP:0002650): The presence of an abnormal lateral curvature of the spine. Evidence: TAS. Frequency: Occasional (HP:0040283). (ORPHA:85278)
- Decreased muscle mass (HP:0003199). Evidence: TAS. Frequency: Occasional (HP:0040283). (ORPHA:85278)
- Epileptic encephalopathy (HP:0200134): A condition in which epileptiform abnormalities are believed to contribute to the progressive disturbance in cerebral function. Epileptic encephalaopathy is characterized by (1) electrographic EEG paroxysmal activity that is often aggressive, (2) seizures that are usually multiform and intractable, (3) cognitive, behavioral and neurological deficits that may be relentless, and (4) sometimes early death. Evidence: TAS. Frequency: Occasional (HP:0040283). (ORPHA:85278)
- Narrow face (HP:0000275): Bizygomatic (upper face) and bigonial (lower face) width are both more than 2 standard deviations below the mean (objective); or, an apparent reduction in the width of the upper and lower face (subjective). Evidence: TAS. Frequency: Very frequent (HP:0040281). (ORPHA:85278)
- Long face (HP:0000276): Facial height (length) is more than 2 standard deviations above the mean (objective); or, an apparent increase in the height (length) of the face (subjective). Evidence: TAS. Frequency: Very frequent (HP:0040281). (ORPHA:85278)
- Macrotia (HP:0000400): Median longitudinal ear length greater than two standard deviations above the mean and median ear width greater than two standard deviations above the mean (objective); or, apparent increase in length and width of the pinna (subjective). Evidence: TAS. Frequency: Very frequent (HP:0040281). (ORPHA:85278)
- Strabismus (HP:0000486): A misalignment of the eyes so that the visual axes deviate from bifoveal fixation. The classification of strabismus may be based on a number of features including the relative position of the eyes, whether the deviation is latent or manifest, intermittent or constant, concomitant or otherwise and according to the age of onset and the relevance of any associated refractive error. Evidence: TAS. Frequency: Very frequent (HP:0040281). (ORPHA:85278)
- Thick eyebrow (HP:0000574): Increased density/number and/or increased diameter of eyebrow hairs. Evidence: TAS. Frequency: Very frequent (HP:0040281). (ORPHA:85278)
- Absent speech (HP:0001344): Complete lack of development of speech and language abilities. Evidence: TAS. Frequency: Very frequent (HP:0040281). (ORPHA:85278)
- Truncal ataxia (HP:0002078): Truncal ataxia is a sign of ataxia characterized by instability of the trunk. It usually occurs during sitting. Evidence: TAS. Frequency: Very frequent (HP:0040281). (ORPHA:85278)
- Profound intellectual disability (HP:0002187): Profound intellectual disability (ID) is defined as a type of ID characterized by profoundly sub-average adaptive functioning and intellectual functioning, with an intelligence quotient (IQ) below 20. Evidence: TAS. Frequency: Very frequent (HP:0040281). (ORPHA:85278)
- Generalized-onset seizure (HP:0002197): A generalized-onset seizure is a type of seizure originating at some point within, and rapidly engaging, bilaterally distributed networks. The networks may include cortical and subcortical structures but not necessarily the entire cortex. Evidence: TAS. Frequency: Very frequent (HP:0040281). (ORPHA:85278)
- Developmental regression (HP:0002376): Loss of developmental skills, as manifested by loss of developmental milestones. Evidence: TAS. Frequency: Very frequent (HP:0040281). (ORPHA:85278)
- Neuronal loss in central nervous system (HP:0002529). Evidence: TAS. Frequency: Very frequent (HP:0040281). (ORPHA:85278)
- Cachexia (HP:0004326): Severe weight loss, wasting of muscle, loss of appetite, and general debility related to a chronic disease. Evidence: TAS. Frequency: Very frequent (HP:0040281). (ORPHA:85278)
- Severe global developmental delay (HP:0011344): A severe delay in the achievement of motor or mental milestones in the domains of development of a child. Evidence: TAS. Frequency: Very frequent (HP:0040281). (ORPHA:85278)
- Open mouth (HP:0000194): A facial appearance characterized by a permanently or nearly permanently opened mouth. Evidence: TAS. Frequency: Frequent (HP:0040282). (ORPHA:85278)
- Microcephaly (HP:0000252): Head circumference below 2 standard deviations below the mean for age and gender. Evidence: TAS. Frequency: Frequent (HP:0040282). (ORPHA:85278)
- Ophthalmoplegia (HP:0000602): Paralysis of one or more extraocular muscles that are responsible for eye movements. Evidence: TAS. Frequency: Frequent (HP:0040282). (ORPHA:85278)
- Nystagmus (HP:0000639): Rhythmic, involuntary oscillations of one or both eyes related to abnormality in fixation, conjugate gaze, or vestibular mechanisms. Evidence: TAS. Frequency: Frequent (HP:0040282). (ORPHA:85278)
- Autism (HP:0000717): Autism is a neurodevelopmental disorder characterized by impaired social interaction and communication, and by restricted and repetitive behavior. Autism begins in childhood. It is marked by the presence of markedly abnormal or impaired development in social interaction and communication and a markedly restricted repertoire of activity and interest. Manifestations of the disorder vary greatly depending on the developmental level and chronological age of the individual (DSM-IV). Evidence: TAS. Frequency: Frequent (HP:0040282). (ORPHA:85278)
- Motor stereotypy (HP:0000733): Use of the same abnormal action in response to certain triggers or at random. They may be used as a way to regulate one's internal state but must otherwise have no apparent functional purpose. Evidence: TAS. Frequency: Frequent (HP:0040282). (ORPHA:85278)
- Inappropriate laughter (HP:0000748): Laughing that may be excessive and/or inappropriate in context (e.g., laughing at a funeral while others are crying). Evidence: TAS. Frequency: Frequent (HP:0040282). (ORPHA:85278)
- Abnormal thorax morphology (HP:0000765): Any abnormality of the thorax (the region of the body formed by the sternum, the thoracic vertebrae and the ribs). Evidence: TAS. Frequency: Frequent (HP:0040282). (ORPHA:85278)
- Pectus excavatum (HP:0000767): A defect of the chest wall characterized by a depression of the sternum, giving the chest ("pectus") a caved-in ("excavatum") appearance. Evidence: TAS. Frequency: Frequent (HP:0040282). (ORPHA:85278)
- Adducted thumb (HP:0001181): In the resting position, the tip of the thumb is on, or near, the palm, close to the base of the fourth or fifth finger. Evidence: TAS. Frequency: Frequent (HP:0040282). (ORPHA:85278)
- Seizure (HP:0001250): A seizure is an intermittent abnormality of nervous system physiology characterized by a transient occurrence of signs and/or symptoms due to abnormal excessive or synchronous neuronal activity in the brain. Evidence: TAS. Frequency: Frequent (HP:0040282). (ORPHA:85278)
- Cerebellar atrophy (HP:0001272): Cerebellar atrophy is defined as a cerebellum with initially normal structures, in a posterior fossa with normal size, which displays enlarged fissures (interfolial spaces) in comparison to the foliae secondary to loss of tissue. Cerebellar atrophy implies irreversible loss of tissue and result from an ongoing progressive disease until a final stage is reached or a single injury, e.g. an intoxication or infectious event. Evidence: TAS. Frequency: Frequent (HP:0040282). (ORPHA:85278)
- Failure to thrive (HP:0001508): Failure to thrive (FTT) refers to a child whose physical growth is substantially below the norm. Evidence: TAS. Frequency: Frequent (HP:0040282). (ORPHA:85278)
- Dysphagia (HP:0002015): Difficulty in swallowing. Evidence: TAS. Frequency: Frequent (HP:0040282). (ORPHA:85278)
- Constipation (HP:0002019): Infrequent or difficult evacuation of feces. Evidence: TAS. Frequency: Frequent (HP:0040282). (ORPHA:85278)
- Gastroesophageal reflux (HP:0002020): A condition in which the stomach contents leak backwards from the stomach into the esophagus through the lower esophageal sphincter. Evidence: TAS. Frequency: Frequent (HP:0040282). (ORPHA:85278)
- Gait ataxia (HP:0002066): A type of ataxia characterized by the impairment of the ability to coordinate the movements required for normal walking. Gait ataxia is characteirzed by a wide-based staggering gait with a tendency to fall. Evidence: TAS. Frequency: Frequent (HP:0040282). (ORPHA:85278)
- Ventriculomegaly (HP:0002119): An increase in size of the ventricular system of the brain. Evidence: TAS. Frequency: Frequent (HP:0040282). (ORPHA:85278)
- Cerebral cortical atrophy (HP:0002120): Atrophy of the cortex of the cerebrum. Evidence: TAS. Frequency: Frequent (HP:0040282). (ORPHA:85278)
- Delayed gross motor development (HP:0002194): A type of motor delay characterized by a delay in acquiring the ability to control the large muscles of the body for walking, running, sitting, and crawling. Evidence: TAS. Frequency: Frequent (HP:0040282). (ORPHA:85278)
- Mutism (HP:0002300): Complete lack of speech or verbal communication in a person despite attempts to engage in conversation. Mutism as a phenomena assumes the individual has previous capacity for speech and in the pediatric population it assumes that the person is past the age of typical language development. Evidence: TAS. Frequency: Frequent (HP:0040282). (ORPHA:85278)
- Joint hypermobility (HP:0001382): The capability that a joint (or a group of joints) has to move, passively and/or actively, beyond normal limits along physiological axes. Evidence: TAS. Frequency: Occasional (HP:0040283). (ORPHA:85278)